Phenotypes associated with the disease autosomal dominant nonsyndromic hearing loss 16 (OMIM:603964):
- Tinnitus (HP:0000360): Tinnitus is an auditory perception that can be described as the experience of sound, in the ear or in the head, in the absence of external acoustic stimulation. Evidence: TAS. Frequency: Occasional (HP:0040283). (OMIM:603964)
- Adult onset sensorineural hearing impairment (HP:0008615): The presence of sensorineural deafness with late onset. Evidence: IEA. (OMIM:603964)
- Autosomal dominant inheritance (HP:0000006): A mode of inheritance that is observed for traits related to a gene encoded on one of the autosomes (i.e., the human chromosomes 1-22) in which a trait manifests in heterozygotes. In the context of medical genetics, an autosomal dominant disorder is caused when a single copy of the mutant allele is present. Males and females are affected equally, and can both transmit the disorder with a risk of 50% for each child of inheriting the mutant allele. Evidence: IEA. (OMIM:603964)